- Delayed speech and language development (HP:0000750): A degree of language development that is significantly below the norm for a child of a specified age. Evidence: PCS. Frequency: 1/3. (PMID:17333282)
- Moderate intellectual disability (HP:0002342): Moderate intellectual disability (ID) is defined as a type of ID characterized by moderately sub-average adaptive functioning and intellectual functioning, with an intelligence quotient (IQ) the range of 35-49. Evidence: PCS. Frequency: 4/4. (PMID:8288232)
- Seizure (HP:0001250): A seizure is an intermittent abnormality of nervous system physiology characterized by a transient occurrence of signs and/or symptoms due to abnormal excessive or synchronous neuronal activity in the brain. Evidence: IEA. Frequency: Occasional (HP:0040283). (OMIM:309549)
- Global developmental delay (HP:0001263): A delay in the achievement of motor or mental milestones in the domains of development of a child, including motor skills, speech and language, cognitive skills, and social and emotional skills. This term should only be used to describe children younger than five years of age. Evidence: PCS. Frequency: 3/3. (PMID:17333282)
- Infantile onset (HP:0003593): Onset of signs or symptoms of disease between 28 days to one year of life. Evidence: PCS. (PMID:15162322)
- Delayed gross motor development (HP:0002194): A type of motor delay characterized by a delay in acquiring the ability to control the large muscles of the body for walking, running, sitting, and crawling. Evidence: PCS. Frequency: 1/3. (PMID:17333282)
- Depressed nasal bridge (HP:0005280): Posterior positioning of the nasal root in relation to the overall facial profile for age. Evidence: PCS. Frequency: 1/3. (PMID:17333282)
- Schizophrenia (HP:0100753): A mental disorder characterized by a disintegration of thought processes and emotional responsiveness. It most commonly manifests as auditory hallucinations, paranoid or bizarre delusions, or disorganized speech and thinking. It is accompanied by significant social or occupational dysfunction. The onset of symptoms typically occurs in young adulthood, with a global lifetime prevalence of about 1%. This term is not a helpful parent term to describe abnormal experiences. Evidence: PCS. Frequency: 1/14. (PMID:15162322)
- X-linked recessive inheritance (HP:0001419): A mode of inheritance that is observed for recessive traits related to a gene encoded on the X chromosome. In the context of medical genetics, X-linked recessive disorders manifest in males (who have one copy of the X chromosome and are thus hemizygotes), but generally not in female heterozygotes who have one mutant and one normal allele. Evidence: PCS. (PMID:15162322)
- Childhood onset (HP:0011463): Onset of disease at the age of between 1 and 5 years. Evidence: PCS. (PMID:15162322)
- Aggressive behavior (HP:0000718): Behavior or an act aimed at harming a person, animal, or physical property (e.g., acts of physical violence; shouting, swearing, and using harsh language; slashing someone's tires). Evidence: PCS. Frequency: 5/14. (PMID:15162322)
- Periorbital fullness (HP:0000629): Increase in periorbital soft tissue. Evidence: TAS. (OMIM:309549)
- Autism (HP:0000717): Autism is a neurodevelopmental disorder characterized by impaired social interaction and communication, and by restricted and repetitive behavior. Autism begins in childhood. It is marked by the presence of markedly abnormal or impaired development in social interaction and communication and a markedly restricted repertoire of activity and interest. Manifestations of the disorder vary greatly depending on the developmental level and chronological age of the individual (DSM-IV). Evidence: PCS. Frequency: 1/3. Onset: Infantile onset (HP:0003593). (PMID:17333282)
- Anxiety (HP:0000739): Intense feelings of nervousness, tension, or panic often arise in response to interpersonal stresses. There is worry about the negative effects of past unpleasant experiences and future negative possibilities. Individuals may feel fearful, apprehensive, or threatened by uncertainty, and they may also have fears of falling apart or losing control. Evidence: PCS. Frequency: 2/14. (PMID:15162322)
- Short distal phalanx of finger (HP:0009882): Short distance from the end of the finger to the most distal interphalangeal crease or the distal interphalangeal joint flexion point. That is, hypoplasia of one or more of the distal phalanx of finger. Evidence: PCS. Frequency: 1/3. (PMID:17333282)
- Long palpebral fissure (HP:0000637): Distance between medial and lateral canthi is more than two standard deviations above the mean for age (objective); or, apparently increased length of the palpebral fissures. Evidence: TAS. (OMIM:309549)
- Macrotia (HP:0000400): Median longitudinal ear length greater than two standard deviations above the mean and median ear width greater than two standard deviations above the mean (objective); or, apparent increase in length and width of the pinna (subjective). Evidence: PCS. Frequency: 3/4. (PMID:8288232)
- Thick lower lip vermilion (HP:0000179): Increased thickness of the lower lip, leading to a prominent appearance of the lower lip. The height of the vermilion of the lower lip in the midline is more than 2 SD above the mean. Alternatively, an apparently increased height of the vermilion of the lower lip in the frontal view (subjective). Evidence: TAS. (OMIM:309549)
- Intellectual disability (HP:0001249): The term intellectual disability or intellectual developmental disorder is used to describe significantly sub-average intellectual and adaptive functioning based on clinical assessment and as measured by individually administered, appropriately normed, standardized and validated tests of intellectual functioning and adaptive behavior, with onset during the developmental period from infancy through adolescence. Evidence: PCS. Frequency: 14/14. (PMID:15162322)
These phenotypes are associated with the disease intellectual disability, X-linked 9 (OMIM:309549).